- Corneal degeneration (HP:0007705). Evidence: TAS. (OMIM:610158)
- Edema (HP:0000969): An abnormal accumulation of fluid beneath the skin, or in one or more cavities of the body. Evidence: TAS. (OMIM:610158)
- Corneal dystrophy (HP:0001131): The term corneal dystrophy embraces a heterogenous group of bilateral genetically determined non-inflammatory corneal diseases that are restricted to the cornea. Evidence: IEA. (OMIM:610158)
- Corneal guttata (HP:0012038): Corneal guttata are droplet-like accumulations of non-banded collagen on the posterior surface of Descemet's membrane. The presence of focal thickenings of Descemet's membrane histologically named guttae. Cornea guttata can be easily diagnosed in vivo and ex vivo by means of specular microscopy as it gives dark areas where no endothelial cells are visible. Evidence: TAS. (OMIM:610158)
- Autosomal dominant inheritance (HP:0000006): A mode of inheritance that is observed for traits related to a gene encoded on one of the autosomes (i.e., the human chromosomes 1-22) in which a trait manifests in heterozygotes. In the context of medical genetics, an autosomal dominant disorder is caused when a single copy of the mutant allele is present. Males and females are affected equally, and can both transmit the disorder with a risk of 50% for each child of inheriting the mutant allele. Evidence: TAS. (OMIM:610158)
These phenotypes are associated with the disease corneal dystrophy, fuchs endothelial, 2 (OMIM:610158).